Phenotypes associated with the disease ACETAMINOPHEN METABOLISM (OMIM:100675):
- Autosomal dominant inheritance (HP:0000006): A mode of inheritance that is observed for traits related to a gene encoded on one of the autosomes (i.e., the human chromosomes 1-22) in which a trait manifests in heterozygotes. In the context of medical genetics, an autosomal dominant disorder is caused when a single copy of the mutant allele is present. Males and females are affected equally, and can both transmit the disorder with a risk of 50% for each child of inheriting the mutant allele. Evidence: TAS. (OMIM:100675)
- Jaundice (HP:0000952): Yellow pigmentation of the skin due to bilirubin, which in turn is the result of increased bilirubin concentration in the bloodstream. Evidence: TAS. (OMIM:100675)